- Sporadic (HP:0003745): Cases of the disease in question occur without a previous family history, i.e., as isolated cases without being transmitted from a parent and without other siblings being affected. Evidence: PCS. (PMID:19921637)
- Cleft ala nasi (HP:0003191): The presence of a notch in the margin of the ala nasi. Evidence: PCS. (PMID:19921637)
These phenotypes are associated with the disease alar cleft, isolated (OMIM:614687).